- Seizure (HP:0001250): A seizure is an intermittent abnormality of nervous system physiology characterized by a transient occurrence of signs and/or symptoms due to abnormal excessive or synchronous neuronal activity in the brain. Evidence: IEA. (OMIM:245180)
- Autosomal recessive inheritance (HP:0000007): A mode of inheritance that is observed for traits related to a gene encoded on one of the autosomes (i.e., the human chromosomes 1-22) in which a trait manifests in individuals with two pathogenic alleles, either homozygotes (two copies of the same mutant allele) or compound heterozygotes (whereby each copy of a gene has a distinct mutant allele). Evidence: TAS. (OMIM:245180)
- Intellectual disability (HP:0001249): The term intellectual disability or intellectual developmental disorder is used to describe significantly sub-average intellectual and adaptive functioning based on clinical assessment and as measured by individually administered, appropriately normed, standardized and validated tests of intellectual functioning and adaptive behavior, with onset during the developmental period from infancy through adolescence. Evidence: IEA. (OMIM:245180)
- Transient psychotic episodes (HP:0006932): Relatively short-lived periods of psychosis are characterized by the sudden onset of severe disturbances in perception, thinking, and behavior. These episodes typically last for a brief duration, generally ranging from a few days to a few weeks, and are often triggered by a significant stressor or traumatic event. Evidence: IEA. (OMIM:245180)
These phenotypes are associated with the disease Kifafa seizure disorder (OMIM:245180).